- Menorrhagia (HP:0000132): Prolonged and excessive menses at regular intervals in excess of 80 mL or lasting longer than 7 days. Evidence: TAS. Frequency: Frequent (HP:0040282). (ORPHA:168816)
- Weight loss (HP:0001824): Reduction of total body weight. Evidence: TAS. Frequency: Frequent (HP:0040282). (ORPHA:168816)
- Constipation (HP:0002019): Infrequent or difficult evacuation of feces. Evidence: TAS. Frequency: Very frequent (HP:0040281). (ORPHA:168816)
- Abdominal pain (HP:0002027): An unpleasant sensation characterized by physical discomfort (such as pricking, throbbing, or aching) and perceived to originate in the abdomen. Evidence: TAS. Frequency: Very frequent (HP:0040281). (ORPHA:168816)
- Peritonitis (HP:0002586): Inflammation of the peritoneum. Evidence: TAS. Frequency: Very frequent (HP:0040281). (ORPHA:168816)
- Neoplasm (HP:0002664): An organ or organ-system abnormality that consists of uncontrolled autonomous cell-proliferation which can occur in any part of the body as a benign or malignant neoplasm (tumor). Evidence: TAS. Frequency: Very frequent (HP:0040281). (ORPHA:168816)
- Abdominal distention (HP:0003270): Distention of the abdomen. Evidence: TAS. Frequency: Very frequent (HP:0040281). (ORPHA:168816)
- Dyspareunia (HP:0030016): Recurrent or persistent genital pain associated with sexual intercourse. Evidence: TAS. Frequency: Frequent (HP:0040282). (ORPHA:168816)
- Metrorrhagia (HP:0100608): Bleeding at irregular intervals. Evidence: TAS. Frequency: Frequent (HP:0040282). (ORPHA:168816)
These phenotypes are associated with the disease Peritoneal inclusion cyst (ORPHA:168816).